- Sloping forehead (HP:0000340): Inclination of the anterior surface of the forehead from the vertical more than two standard deviations above the mean (objective); or apparently excessive posterior sloping of the forehead in a lateral view. Evidence: PCS. Frequency: 3/3. (PMID:25218063)
- Congenital onset (HP:0003577): A phenotypic abnormality that is present at birth. Evidence: PCS. Frequency: 14/14. (PMID:25218063;PMID:19215732)
- Absent speech (HP:0001344): Complete lack of development of speech and language abilities. Evidence: PCS. Frequency: 3/3. (PMID:25218063)
- Seizure (HP:0001250): A seizure is an intermittent abnormality of nervous system physiology characterized by a transient occurrence of signs and/or symptoms due to abnormal excessive or synchronous neuronal activity in the brain. Evidence: PCS. Frequency: 0/3. (PMID:25218063)
- Global developmental delay (HP:0001263): A delay in the achievement of motor or mental milestones in the domains of development of a child, including motor skills, speech and language, cognitive skills, and social and emotional skills. This term should only be used to describe children younger than five years of age. Evidence: PCS. Frequency: 11/11. (PMID:25218063;PMID:19215732)
- Primary microcephaly (HP:0011451): Head circumference below 2 standard deviations below the mean for age and gender at birth. Evidence: PCS. Frequency: 11/11. (PMID:25218063;PMID:19215732)
- Prominent nose (HP:0000448): Distance between subnasale and pronasale more than two standard deviations above the mean, or alternatively, an apparently increased anterior protrusion of the nasal tip. Evidence: PCS. Frequency: 3/3. (PMID:25218063)
- Autosomal recessive inheritance (HP:0000007): A mode of inheritance that is observed for traits related to a gene encoded on one of the autosomes (i.e., the human chromosomes 1-22) in which a trait manifests in individuals with two pathogenic alleles, either homozygotes (two copies of the same mutant allele) or compound heterozygotes (whereby each copy of a gene has a distinct mutant allele). Evidence: PCS. (PMID:19215732)
- Intellectual disability (HP:0001249): The term intellectual disability or intellectual developmental disorder is used to describe significantly sub-average intellectual and adaptive functioning based on clinical assessment and as measured by individually administered, appropriately normed, standardized and validated tests of intellectual functioning and adaptive behavior, with onset during the developmental period from infancy through adolescence. Evidence: PCS. Frequency: 8/8. (PMID:19215732)
- Solitary median maxillary central incisor (HP:0006315): A single maxillary central incisor positioned in the midline with morphological symmetry of the crown and bordered by lateral incisors. Evidence: PCS. Frequency: 0/3. (PMID:25218063)
- Simplified gyral pattern (HP:0009879): An abnormality of the cerebral cortex with fewer gyri but with normal cortical thickness. This pattern is usually often associated with congenital microcephaly. Evidence: PCS. Frequency: 2/2. (PMID:25218063)
- Severe intellectual disability (HP:0010864): Severe intellectual disability (ID) is defined as a type of ID characterized by severely sub-average adaptive functioning and intellectual functioning, with an intelligence quotient (IQ) the range of 20-34. Evidence: PCS. Frequency: 3/3. (PMID:25218063)
These phenotypes are associated with the disease microcephaly 7, primary, autosomal recessive (OMIM:612703).